- Constriction of peripheral visual field (HP:0001133): An absolute or relative decrease in retinal sensitivity extending from edge (periphery) of the visual field in a concentric pattern. The visual field is the area that is perceived simultaneously by a fixating eye. Evidence: TAS. (OMIM:612989)
- Strabismus (HP:0000486): A misalignment of the eyes so that the visual axes deviate from bifoveal fixation. The classification of strabismus may be based on a number of features including the relative position of the eyes, whether the deviation is latent or manifest, intermittent or constant, concomitant or otherwise and according to the age of onset and the relevance of any associated refractive error. Evidence: TAS. Frequency: Occasional (HP:0040283). (OMIM:612989)
- Pallor (HP:0000980): Abnormally pale skin. Evidence: IEA. (OMIM:612989)
- Hypertrophic cardiomyopathy (HP:0001639): Hypertrophic cardiomyopathy (HCM) is defined by the presence of increased ventricular wall thickness or mass in the absence of loading conditions (hypertension, valve disease) sufficient to cause the observed abnormality. Evidence: TAS. Frequency: Occasional (HP:0040283). (OMIM:612989)
- Sensorineural hearing impairment (HP:0000407): A type of hearing impairment in one or both ears related to an abnormal functionality of the cochlear nerve. Evidence: TAS. Frequency: Occasional (HP:0040283). (OMIM:612989)
- Variable expressivity (HP:0003828): A variable severity of phenotypic features. Evidence: TAS. (OMIM:612989)
- Autosomal recessive inheritance (HP:0000007): A mode of inheritance that is observed for traits related to a gene encoded on one of the autosomes (i.e., the human chromosomes 1-22) in which a trait manifests in individuals with two pathogenic alleles, either homozygotes (two copies of the same mutant allele) or compound heterozygotes (whereby each copy of a gene has a distinct mutant allele). Evidence: PCS. (PMID:19327736)
- Dyschromatopsia (HP:0007641): A form of colorblindness in which only two of the three fundamental colors can be distinguished due to a lack of one of the retinal cone pigments. Evidence: TAS. (OMIM:612989)
- Reduced visual acuity (HP:0007663). Evidence: TAS. (OMIM:612989)
- Visual impairment (HP:0000505): Visual impairment (or vision impairment) is vision loss (of a person) to such a degree as to qualify as an additional support need through a significant limitation of visual capability resulting from either disease, trauma, or congenital or degenerative conditions that cannot be corrected by conventional means, such as refractive correction, medication, or surgery. Evidence: PCS. Onset: Childhood onset (HP:0011463). (PMID:19327736)
- Optic atrophy (HP:0000648): Atrophy of the optic nerve. Optic atrophy results from the death of the retinal ganglion cell axons that comprise the optic nerve and manifesting as a pale optic nerve on fundoscopy. Evidence: TAS. (OMIM:612989)
- Central scotoma (HP:0000603): An area of depressed vision located at the point of fixation and that interferes with central vision. Evidence: PCS. Onset: Childhood onset (HP:0011463). (PMID:19327736)
- Optic disc pallor (HP:0000543): A pale yellow discoloration of the optic disc (the area of the optic nerve head in the retina). The optic disc normally has a pinkish hue with a central yellowish depression. Evidence: PCS. (PMID:19327736)
- Horizontal nystagmus (HP:0000666): Nystagmus consisting of horizontal to-and-fro eye movements. Evidence: TAS. Frequency: Occasional (HP:0040283). (OMIM:612989)
These phenotypes are associated with the disease autosomal recessive optic atrophy, OPA7 type (OMIM:612989).